- Sparse scalp hair (HP:0002209): Decreased number of hairs per unit area of skin of the scalp. Evidence: TAS. Frequency: Frequent (HP:0040282). (ORPHA:492)
- Epidermoid cyst (HP:0200040): Nontender, round and firm, but slightly compressible, intradermal or subcutaneous cyst measuring 0.5-5 cm in diameter. Epidermal cysts are intradermal or subcutaneous tumors, grow slowly and occur on the face, neck, back and scrotum. They usually appear at or around puberty, and as a rule an affected individual has one solitary or a few cysts. A central, dark comedone opening (punctum) may be present. Evidence: TAS. Frequency: Very frequent (HP:0040281). (ORPHA:492)
- Skin ulcer (HP:0200042): A discontinuity of the skin exhibiting complete loss of the epidermis and often portions of the dermis and even subcutaneous fat. Evidence: TAS. Frequency: Very frequent (HP:0040281). (ORPHA:492)
These phenotypes are associated with the disease Proliferating trichilemmal cyst (ORPHA:492).